Phenotypes associated with the disease ring chromosome 14 (OMIM:616606):
- Poor speech (HP:0002465). Evidence: TAS. (OMIM:616606)
- Epicanthus (HP:0000286): A fold of skin starting above the medial aspect of the upper eyelid and arching downward to cover, pass in front of and lateral to the medial canthus. Evidence: TAS. (OMIM:616606)
- Anteverted nares (HP:0000463): Anteriorly-facing nostrils viewed with the head in the Frankfurt horizontal and the eyes of the observer level with the eyes of the subject. This gives the appearance of an upturned nose (upturned nasal tip). Evidence: TAS. (OMIM:616606)
- Focal impaired awareness seizure (HP:0002384): Focal impaired awareness seizure (or focal seizure with impaired or lost awareness) is a type of focal-onset seizure characterized by some degree (which may be partial) of impairment of the person's awareness of themselves or their surroundings at any point during the seizure. Evidence: PCS. Frequency: 1/1. (PMID:23610869)
- Hypotonia (HP:0001252): Hypotonia is an abnormally low muscle tone (the amount of tension or resistance to movement in a muscle). Even when relaxed, muscles have a continuous and passive partial contraction which provides some resistance to passive stretching. Hypotonia thus manifests as diminished resistance to passive stretching. Hypotonia is not the same as muscle weakness, although the two conditions can co-exist. Evidence: TAS. (OMIM:616606)
- Blepharophimosis (HP:0000581): A fixed reduction in the vertical distance between the upper and lower eyelids with short palpebral fissures. Evidence: PCS. Frequency: 1/1. (PMID:23610869)
- Pigmentary retinopathy (HP:0000580): An abnormality of the retina characterized by pigment deposition. It is typically associated with migration and proliferation of macrophages or retinal pigment epithelial cells into the retina; melanin from these cells causes the pigmentary changes. Pigmentary retinopathy is a common final pathway of many retinal conditions and is often associated with visual loss. Evidence: TAS. Frequency: Occasional (HP:0040283). (OMIM:616606)
- Infantile onset (HP:0003593): Onset of signs or symptoms of disease between 28 days to one year of life. Evidence: PCS. Frequency: 1/1. (PMID:23610869)
- Generalized hypotonia (HP:0001290): Generalized muscular hypotonia (abnormally low muscle tone). Evidence: TAS. (OMIM:616606)
- Hypertelorism (HP:0000316): Interpupillary distance more than 2 SD above the mean (alternatively, the appearance of an increased interpupillary distance or widely spaced eyes). Evidence: TAS. (OMIM:616606)
- High palate (HP:0000218): Height of the palate more than 2 SD above the mean (objective) or palatal height at the level of the first permanent molar more than twice the height of the teeth (subjective). Evidence: TAS. (OMIM:616606)
- Sporadic (HP:0003745): Cases of the disease in question occur without a previous family history, i.e., as isolated cases without being transmitted from a parent and without other siblings being affected. Evidence: TAS. (OMIM:616606)
- Intellectual disability (HP:0001249): The term intellectual disability or intellectual developmental disorder is used to describe significantly sub-average intellectual and adaptive functioning based on clinical assessment and as measured by individually administered, appropriately normed, standardized and validated tests of intellectual functioning and adaptive behavior, with onset during the developmental period from infancy through adolescence. Evidence: TAS. (OMIM:616606)
- Depressed nasal ridge (HP:0000457): Lack of prominence of the nose resulting from a posteriorly-placed nasal ridge. Evidence: PCS. Frequency: 1/1. (PMID:23610869)
- Flat occiput (HP:0005469): Reduced convexity of the occiput (posterior part of skull). Evidence: TAS. (OMIM:616606)
- Microcephaly (HP:0000252): Head circumference below 2 standard deviations below the mean for age and gender. Evidence: TAS. (OMIM:616606)
- Downslanted palpebral fissures (HP:0000494): The palpebral fissure inclination is more than two standard deviations below the mean. Evidence: TAS. (OMIM:616606)
- Status epilepticus (HP:0002133): Status epilepticus is a type of prolonged seizure resulting either from the failure of the mechanisms responsible for seizure termination or from the initiation of mechanisms which lead to abnormally prolonged seizures (after time point t1). It is a condition that can have long-term consequences (after time point t2), including neuronal death, neuronal injury, and alteration of neuronal networks, depending on the type and duration of seizures. Evidence: TAS. (OMIM:616606)
- Delayed speech and language development (HP:0000750): A degree of language development that is significantly below the norm for a child of a specified age. Evidence: PCS. Frequency: 1/1. (PMID:23610869)
- Generalized-onset seizure (HP:0002197): A generalized-onset seizure is a type of seizure originating at some point within, and rapidly engaging, bilaterally distributed networks. The networks may include cortical and subcortical structures but not necessarily the entire cortex. Evidence: PCS. Frequency: 1/1. (PMID:23610869)
- Global developmental delay (HP:0001263): A delay in the achievement of motor or mental milestones in the domains of development of a child, including motor skills, speech and language, cognitive skills, and social and emotional skills. This term should only be used to describe children younger than five years of age. Evidence: PCS. Frequency: 1/1. (PMID:23610869)
- Short neck (HP:0000470): Diminished length of the neck. Evidence: TAS. (OMIM:616606)
- Depressed nasal bridge (HP:0005280): Posterior positioning of the nasal root in relation to the overall facial profile for age. Evidence: TAS. (OMIM:616606)
- Almond-shaped palpebral fissure (HP:0007874): A shape created by an acute downward arching of the upper eyelid and upward arching of the lower eyelid, toward the medial canthus, which gives the outline of the palpebral fissures the configuration of an almond. Thus, the maximum distance between the fissures is offset from, and medial to, the center point. Evidence: PCS. Frequency: 1/1. (PMID:23610869)
- Dolichocephaly (HP:0000268): An abnormality of skull shape characterized by a increased anterior-posterior diameter, i.e., an increased antero-posterior dimension of the skull. Cephalic index less than 76%. Alternatively, an apparently increased antero-posterior length of the head compared to width. Often due to premature closure of the sagittal suture. Evidence: TAS. (OMIM:616606)
- Growth delay (HP:0001510): A deficiency or slowing down of growth pre- and postnatally. Evidence: TAS. (OMIM:616606)
- Focal-onset seizure (HP:0007359): A focal-onset seizure is a type of seizure originating within networks limited to one hemisphere. They may be discretely localized or more widely distributed, and may originate in subcortical structures. Evidence: PCS. Frequency: 1/1. (PMID:23610869)
- Low-set ears (HP:0000369): Upper insertion of the ear to the scalp below an imaginary horizontal line drawn between the inner canthi of the eye and extending posteriorly to the ear. Evidence: TAS. (OMIM:616606)